Phenotypes associated with the disease Noonan syndrome 9 (OMIM:616559):
- Curly hair (HP:0002212). Evidence: PCS. Frequency: 4/5. (PMID:25795793)
- Downslanted palpebral fissures (HP:0000494): The palpebral fissure inclination is more than two standard deviations below the mean. Evidence: PCS. (PMID:25795793)
- Prominent corneal nerve fibers (HP:0010726): Abnormal prominence of the corneal nerve fibers. Evidence: PCS. Frequency: 1/2. (PMID:25795793)
- Short stature (HP:0004322): A height below that which is expected according to age and gender norms. Although there is no universally accepted definition of short stature, many refer to "short stature" as height more than 2 standard deviations below the mean for age and gender (or below the 3rd percentile for age and gender dependent norms). Evidence: PCS. Frequency: 2/4. (PMID:25795793)
- Hydroureter (HP:0000072): The distention of the ureter with urine. Evidence: PCS. Frequency: 1/5. (PMID:25795793)
- Global developmental delay (HP:0001263): A delay in the achievement of motor or mental milestones in the domains of development of a child, including motor skills, speech and language, cognitive skills, and social and emotional skills. This term should only be used to describe children younger than five years of age. Evidence: PCS. Frequency: 2/5. (PMID:25795793)
- Coarctation of aorta (HP:0001680): Coarctation of the aorta is a narrowing or constriction of a segment of the aorta. Evidence: PCS. Frequency: 1/5. (PMID:25795793)
- Short neck (HP:0000470): Diminished length of the neck. Evidence: PCS. Frequency: 5/5. (PMID:25795793)
- Sparse eyebrow (HP:0045075): Decreased density/number of eyebrow hairs. Evidence: PCS. Frequency: 4/5. (PMID:25795793)
- Prolonged prothrombin time (HP:0008151): Increased time to coagulation in the prothrombin time test, which is a measure of the extrinsic pathway of coagulation. The results of the prothrombin time test are often expressed in terms of the International normalized ratio (INR), which is calculated as a ratio of the patient's prothrombin time (PT) to a control PT standardized for the potency of the thromboplastin reagent developed by the World Health Organization (WHO) using the formula: INR is equal to Patient PT divided by Control PT. Evidence: PCS. Frequency: 2/2. (PMID:25795793)
- Keratosis pilaris (HP:0032152): An anomaly of the hair follicles of the skin that typically presents as small, rough, brown folliculocentric papules distributed over characteristic areas of the skin, particularly the outer-upper arms and thighs. Evidence: PCS. Frequency: 3/5. (PMID:25795793)
- Ventricular septal defect (HP:0001629): A hole between the two bottom chambers (ventricles) of the heart. The defect is centered around the most superior aspect of the ventricular septum. Evidence: PCS. Frequency: 1/5. (PMID:25795793)
- Ptosis (HP:0000508): The upper eyelid margin is positioned 3 mm or more lower than usual and covers the superior portion of the iris (objective); or, the upper lid margin obscures at least part of the pupil (subjective). Evidence: PCS. (PMID:25795793)
- Hypertelorism (HP:0000316): Interpupillary distance more than 2 SD above the mean (alternatively, the appearance of an increased interpupillary distance or widely spaced eyes). Evidence: PCS. (PMID:25795793)
- Pulmonic stenosis (HP:0001642): A narrowing of the right ventricular outflow tract that can occur at the pulmonary valve (valvular stenosis), below the pulmonary valve (infundibular stenosis), or above the pulmonary valve (supravalvar stenosis). Evidence: PCS. Frequency: 1/5. (PMID:25795793)
- Webbed neck (HP:0000465): Pterygium colli is a congenital skin fold that runs along the sides of the neck down to the shoulders. It involves an ectopic fibrotic facial band superficial to the trapezius muscle. Excess hair-bearing skin is also present and extends down the cervical region well beyond the normal hairline. Evidence: PCS. Frequency: 5/5. (PMID:25795793)
- Cryptorchidism (HP:0000028): Testis in inguinal canal. That is, absence of one or both testes from the scrotum owing to failure of the testis or testes to descend through the inguinal canal to the scrotum. Evidence: PCS. Frequency: 1/1. (PMID:25795793)
- Autosomal dominant inheritance (HP:0000006): A mode of inheritance that is observed for traits related to a gene encoded on one of the autosomes (i.e., the human chromosomes 1-22) in which a trait manifests in heterozygotes. In the context of medical genetics, an autosomal dominant disorder is caused when a single copy of the mutant allele is present. Males and females are affected equally, and can both transmit the disorder with a risk of 50% for each child of inheriting the mutant allele. Evidence: PCS. (PMID:25795793)